Phenotypes associated with the disease teratoma, pineal (OMIM:273120):
- Diplopia (HP:0000651): Diplopia is a condition in which a single object is perceived as two images, it is also known as double vision. Evidence: IEA. (OMIM:273120)
- Nystagmus (HP:0000639): Rhythmic, involuntary oscillations of one or both eyes related to abnormality in fixation, conjugate gaze, or vestibular mechanisms. Evidence: IEA. (OMIM:273120)
- Polydipsia (HP:0001959): Excessive thirst manifested by excessive fluid intake. Evidence: IEA. (OMIM:273120)
- Teratoma (HP:0009792): The presence of a teratoma. Evidence: IEA. (OMIM:273120)
- Abnormal abdomen morphology (HP:0001438): A structural abnormality of the abdomen ('belly'), that is, the part of the body between the pelvis and the thorax. Evidence: IEA. (OMIM:273120)
- Autosomal recessive inheritance (HP:0000007): A mode of inheritance that is observed for traits related to a gene encoded on one of the autosomes (i.e., the human chromosomes 1-22) in which a trait manifests in individuals with two pathogenic alleles, either homozygotes (two copies of the same mutant allele) or compound heterozygotes (whereby each copy of a gene has a distinct mutant allele). Evidence: IEA. (OMIM:273120)
- Polyuria (HP:0000103): An increased rate of urine production. Evidence: IEA. (OMIM:273120)
- Hemiparesis (HP:0001269): Loss of strength in the arm, leg, and sometimes face on one side of the body. Hemiplegia refers to a complete loss of strength, whereas hemiparesis refers to an incomplete loss of strength. Evidence: IEA. (OMIM:273120)
- Cerebral calcification (HP:0002514): The presence of calcium deposition within the cerebrum. Evidence: IEA. (OMIM:273120)